- Arachnodactyly (HP:0001166): Abnormally long and slender fingers (spider fingers). Evidence: IEA. (OMIM:245010)
- Severe periodontitis (HP:0000166): Increased susceptibility to periodontitis, as manifested by severe periodontal infection with rapid alveolar bone loss, tooth mobility, and premature tooth exfoliation. Evidence: IEA. Onset: Infantile onset (HP:0003593). (OMIM:245010)
- Onychogryphosis (HP:0001805): Onychogryphosis is a disorder of nail plate growth that is clinically characterized by an opaque, yellow-brown thickening of the nail plate with associated gross hyperkeratosis, elongation, and increased curvature. Evidence: IEA. (OMIM:245010)
- Osteolytic defects of the phalanges of the hand (HP:0009771): Dissolution or degeneration of bone tissue of the phalanges of the hand. Evidence: IEA. (OMIM:245010)
- Autosomal recessive inheritance (HP:0000007): A mode of inheritance that is observed for traits related to a gene encoded on one of the autosomes (i.e., the human chromosomes 1-22) in which a trait manifests in individuals with two pathogenic alleles, either homozygotes (two copies of the same mutant allele) or compound heterozygotes (whereby each copy of a gene has a distinct mutant allele). Evidence: IEA. (OMIM:245010)
- Tapering pointed ends of distal finger phalanges (HP:0006224): A reduction in diameter of the distal phalanx of finger towards the distal end such that the tip of the phalanx comes to a point (this feature can be observed on radiograms). Evidence: IEA. (OMIM:245010)
- Congenital palmoplantar hyperkeratosis (HP:0007545): Abnormal thickening of the skin on the palms and soles that is present at birth. Evidence: IEA. (OMIM:245010)
- Pes planus (HP:0001763): A foot where the longitudinal arch of the foot is in contact with the ground or floor when the individual is standing; or, in a patient lying supine, a foot where the arch is in contact with the surface of a flat board pressed against the sole of the foot by the examiner with a pressure similar to that expected from weight bearing; or, the height of the arch is reduced. Evidence: IEA. (OMIM:245010)
- Recurrent bacterial skin infections (HP:0005406): Increased susceptibility to bacterial infections of the skin, as manifested by recurrent episodes of infectious dermatitis. Evidence: IEA. (OMIM:245010)
These phenotypes are associated with the disease Haim-Munk syndrome (OMIM:245010).